Phenotypes associated with the disease brain small vessel disease 3 (OMIM:618360):
- Cerebral atrophy (HP:0002059): Atrophy (wasting, decrease in size of cells or tissue) affecting the cerebrum. Evidence: PCS. Frequency: 1/2. (PMID:30412317)
- Spastic tetraplegia (HP:0002510): Spastic paralysis affecting all four limbs. Evidence: PCS. Frequency: 1/2. (PMID:30412317)
- Seizure (HP:0001250): A seizure is an intermittent abnormality of nervous system physiology characterized by a transient occurrence of signs and/or symptoms due to abnormal excessive or synchronous neuronal activity in the brain. Evidence: PCS. Frequency: 1/2. (PMID:30412317)
- Leukoencephalopathy (HP:0002352): This term describes abnormality of the white matter of the cerebrum resulting from damage to the myelin sheaths of nerve cells. Evidence: PCS. Frequency: 2/2. (PMID:30412317)
- Porencephalic cyst (HP:0002132): A cavity within the cerebral hemisphere, filled with cerebrospinal fluid, that communicates directly with the ventricular system. Evidence: PCS. Frequency: 1/2. (PMID:30412317)
- Global developmental delay (HP:0001263): A delay in the achievement of motor or mental milestones in the domains of development of a child, including motor skills, speech and language, cognitive skills, and social and emotional skills. This term should only be used to describe children younger than five years of age. Evidence: PCS. Frequency: 1/2. (PMID:30412317)
- Hypotonia (HP:0001252): Hypotonia is an abnormally low muscle tone (the amount of tension or resistance to movement in a muscle). Even when relaxed, muscles have a continuous and passive partial contraction which provides some resistance to passive stretching. Hypotonia thus manifests as diminished resistance to passive stretching. Hypotonia is not the same as muscle weakness, although the two conditions can co-exist. Evidence: PCS. Frequency: 1/2. (PMID:30412317)
- Infantile onset (HP:0003593): Onset of signs or symptoms of disease between 28 days to one year of life. Evidence: PCS. Frequency: 2/2. (PMID:30412317)
- Autosomal recessive inheritance (HP:0000007): A mode of inheritance that is observed for traits related to a gene encoded on one of the autosomes (i.e., the human chromosomes 1-22) in which a trait manifests in individuals with two pathogenic alleles, either homozygotes (two copies of the same mutant allele) or compound heterozygotes (whereby each copy of a gene has a distinct mutant allele). Evidence: PCS. (PMID:30412317)
- Lacunar stroke (HP:0032325): A stroke related to a small infarct (2-20 mm in diameter) in the deep cerebral white matter, basal ganglia, or pons, that is presumed to result from the occlusion of a single small perforating artery supplying the subcortical areas of the brain. Evidence: PCS. Frequency: 1/2. (PMID:30412317)
- Cerebral calcification (HP:0002514): The presence of calcium deposition within the cerebrum. Evidence: PCS. Frequency: 2/2. (PMID:30412317)
- Severe intellectual disability (HP:0010864): Severe intellectual disability (ID) is defined as a type of ID characterized by severely sub-average adaptive functioning and intellectual functioning, with an intelligence quotient (IQ) the range of 20-34. Evidence: PCS. Frequency: 1/2. (PMID:30412317)